- Bilateral tonic-clonic seizure (HP:0002069): A bilateral tonic-clonic seizure is a seizure defined by a tonic (bilateral increased tone, lasting seconds to minutes) and then a clonic (bilateral sustained rhythmic jerking) phase. Evidence: TAS. (OMIM:613060)
- Generalized myoclonic seizure (HP:0002123): A generalized myoclonic seizure is a type of generalized motor seizure characterized by bilateral, sudden, brief (<100 ms) involuntary single or multiple contraction of muscles or muscle groups of variable topography (axial, proximal limb, distal). Myoclonus is less regularly repetitive and less sustained than is clonus. Evidence: TAS. (OMIM:613060)
- Febrile seizure (within the age range of 3 months to 6 years) (HP:0002373): A febrile seizure is any type of seizure (most often a generalized tonic-clonic seizure) occurring with fever (at least 38 degrees Celsius) but in the absence of central nervous system infection, severe metabolic disturbance or other alternative precipitant in children between the ages of 3 months and 6 years. Evidence: TAS. Onset: Infantile onset (HP:0003593). (OMIM:613060)
- Febrile seizure (within the age range of 3 months to 6 years) (HP:0002373): A febrile seizure is any type of seizure (most often a generalized tonic-clonic seizure) occurring with fever (at least 38 degrees Celsius) but in the absence of central nervous system infection, severe metabolic disturbance or other alternative precipitant in children between the ages of 3 months and 6 years. Evidence: PCS. (PMID:15115768)
- Generalized non-motor (absence) seizure (HP:0002121): A generalized non-motor (absence) seizure is a type of a type of dialeptic seizure that is of electrographically generalized onset. It is a generalized seizure characterized by an interruption of activities, a blank stare, and usually the person will be unresponsive when spoken to. Any ictal motor phenomena are minor in comparison to these non-motor features. Evidence: TAS. (OMIM:613060)
- Focal-onset seizure (HP:0007359): A focal-onset seizure is a type of seizure originating within networks limited to one hemisphere. They may be discretely localized or more widely distributed, and may originate in subcortical structures. Evidence: TAS. (OMIM:613060)
- Autosomal dominant inheritance (HP:0000006): A mode of inheritance that is observed for traits related to a gene encoded on one of the autosomes (i.e., the human chromosomes 1-22) in which a trait manifests in heterozygotes. In the context of medical genetics, an autosomal dominant disorder is caused when a single copy of the mutant allele is present. Males and females are affected equally, and can both transmit the disorder with a risk of 50% for each child of inheriting the mutant allele. Evidence: PCS. (PMID:15115768)
These phenotypes are associated with the disease epilepsy, idiopathic generalized, susceptibility to, 10 (OMIM:613060).